Phenotypes associated with the disease fatty liver disease, nonalcoholic, susceptibility to, 2 (OMIM:613387):
- Hepatic steatosis (HP:0001397): Steatosis is a term used to denote lipid accumulation within hepatocytes. Evidence: TAS. (OMIM:613387)
- Non-Mendelian inheritance (HP:0001426): A mode of inheritance that depends on genetic determinants in more than one gene. Evidence: TAS. (OMIM:613387)